- Fever (HP:0001945): Body temperature elevated above the normal range. Evidence: TAS. Frequency: Frequent (HP:0040282). (ORPHA:31202)
- Pneumonia (HP:0002090): Inflammation of any part of the lung parenchyma. Evidence: TAS. Frequency: Frequent (HP:0040282). (ORPHA:31202)
- Respiratory tract infection (HP:0011947): An infection of the upper or lower respiratory tract. Evidence: TAS. Frequency: Frequent (HP:0040282). (ORPHA:31202)
- Acute infectious pneumonia (HP:0011949): Acute inflammation of the lung due to an infection. Evidence: TAS. Frequency: Frequent (HP:0040282). (ORPHA:31202)
- Lung abscess (HP:0025044): A circumscribed area of pus or necrotic debris in lung parenchyma, which leads to a cavity, and after formation of bronchopulmonary fistula, can manifest as an air-fluid level inside the cavity. Evidence: TAS. Frequency: Frequent (HP:0040282). (ORPHA:31202)
- Shock (HP:0031273): The state in which profound and widespread reduction of effective tissue perfusion leads first to reversible, and then if prolonged, to irreversible cellular injury. Evidence: TAS. Frequency: Frequent (HP:0040282). (ORPHA:31202)
- Bacteremia (HP:0031864): Presence of viable bacteria in the blood. Evidence: TAS. Frequency: Frequent (HP:0040282). (ORPHA:31202)
- Sepsis (HP:0100806): Sepsis is defined as life-threatening organ dysfunction caused by a dysregulated host response to infection. Evidence: TAS. Frequency: Frequent (HP:0040282). (ORPHA:31202)
- Abnormality of the spleen (HP:0001743): An abnormality of the spleen. Evidence: TAS. Frequency: Occasional (HP:0040283). (ORPHA:31202)
- Osteoarthritis (HP:0002758): Degeneration (wear and tear) of articular cartilage, i.e., of the joint surface. Joint degeneration may be accompanied by osteophytes (bone overgrowth), narrowing of the joint space, regions of sclerosis at the joint surface, or joint deformity. Evidence: TAS. Frequency: Occasional (HP:0040283). (ORPHA:31202)
- Septic arthritis (HP:0003095). Evidence: TAS. Frequency: Occasional (HP:0040283). (ORPHA:31202)
- Hepatitis (HP:0012115): Inflammation of the liver. Evidence: TAS. Frequency: Occasional (HP:0040283). (ORPHA:31202)
- Splenic abscess (HP:0025059): A circumscribed area of pus or necrotic debris in the parenchyma of the spleen. Evidence: TAS. Frequency: Occasional (HP:0040283). (ORPHA:31202)
- Brain abscess (HP:0030049): A collection of pus, immune cells, and other material in the brain. Evidence: TAS. Frequency: Occasional (HP:0040283). (ORPHA:31202)
- Cutaneous abscess (HP:0031292): A circumscribed area of pus or necrotic debris in the skin (within the epidermis or dermis). Evidence: TAS. Frequency: Occasional (HP:0040283). (ORPHA:31202)
- Unusual skin infection (HP:0032162): Increased susceptibility to infection of the skin, nails, or mucous membranes, as manifested by recurrent or severe cutaneous or mucosal infection, or by skin or mucous membrane infection caused by an atypical or opportunistic organism. Evidence: TAS. Frequency: Occasional (HP:0040283). (ORPHA:31202)
- Liver abscess (HP:0100523): A localized, circumscribed collection of purulent material (pus) within the liver parenchyma, typically resulting from a bacterial, parasitic, or fungal infection. Unlike hepatitis, which is often diffuse, an abscess is a focal lesion. Evidence: TAS. Frequency: Occasional (HP:0040283). (ORPHA:31202)
- Cellulitis (HP:0100658): A bacterial infection and inflammation of the skin und subcutaneous tissues. Evidence: TAS. Frequency: Occasional (HP:0040283). (ORPHA:31202)
- Prostatitis (HP:0000024): The presence of inflammation of the prostate. Evidence: TAS. Frequency: Very rare (HP:0040284). (ORPHA:31202)
- Abnormality of the genitourinary system (HP:0000119): The presence of any abnormality of the genitourinary system. Evidence: TAS. Frequency: Very rare (HP:0040284). (ORPHA:31202)
- Abnormal parotid gland morphology (HP:0000197): Any abnormality of the parotid glands, which are the salivary glands that are located in the subcutaneous tissues of the face overlying the mandibular ramus and anterior and inferior to the external ear. Evidence: TAS. Frequency: Very rare (HP:0040284). (ORPHA:31202)
- Foot osteomyelitis (HP:0001886): An infection of bone of the foot. Evidence: TAS. Frequency: Very rare (HP:0040284). (ORPHA:31202)
- Parotitis (HP:0011850): Inflammation of the parotid gland. Evidence: TAS. Frequency: Very rare (HP:0040284). (ORPHA:31202)
These phenotypes are associated with the disease Melioidosis (ORPHA:31202).